- Resting tremor (HP:0002322): A resting tremor occurs when muscles are at rest and becomes less noticeable or disappears when the affected muscles are moved. Resting tremors are often slow and coarse. Evidence: IEA. (OMIM:605909)
- Parkinsonism (HP:0001300): Characteristic neurologic anomaly resulting from degeneration of dopamine-generating cells in the substantia nigra, a region of the midbrain, characterized clinically by shaking, rigidity, slowness of movement and difficulty with walking and gait. Evidence: IEA. (OMIM:605909)
- Bradykinesia (HP:0002067): Bradykinesia literally means slow movement, and is used clinically to denote a slowness in the execution of movement (in contrast to hypokinesia, which is used to refer to slowness in the initiation of movement). Evidence: IEA. (OMIM:605909)
- Urinary urgency (HP:0000012): Urge incontinence is the strong, sudden need to urinate. Evidence: IEA. (OMIM:605909)
- Dystonia (HP:0001332): An abnormally increased muscular tone that causes fixed abnormal postures. There is a slow, intermittent twisting motion that leads to exaggerated turning and posture of the extremities and trunk. Evidence: TAS. (OMIM:605909)
- Rigidity (HP:0002063): Continuous involuntary sustained muscle contraction. When an affected muscle is passively stretched, the degree of resistance remains constant regardless of the rate at which the muscle is stretched. This feature helps to distinguish rigidity from muscle spasticity. Evidence: IEA. (OMIM:605909)
- Infantile onset (HP:0003593): Onset of signs or symptoms of disease between 28 days to one year of life. Evidence: IEA. (OMIM:605909)
- Postural instability (HP:0002172): A tendency to fall or the inability to keep oneself from falling; imbalance. The retropulsion test is widely regarded as the gold standard to evaluate postural instability, Use of the retropulsion test includes a rapid balance perturbation in the backward direction, and the number of balance correcting steps (or total absence thereof) is used to rate the degree of postural instability. Healthy subjects correct such perturbations with either one or two large steps, or without taking any steps, hinging rapidly at the hips while swinging the arms forward as a counterweight. In patients with balance impairment, balance correcting steps are often too small, forcing patients to take more than two steps. Taking three or more steps is generally considered to be abnormal, and taking more than five steps is regarded as being clearly abnormal. Markedly affected patients continue to step backward without ever regaining their balance and must be caught by the examiner (this would be called true retropulsion). Even more severely affected patients fail to correct entirely, and fall backward like a pushed toy soldier, without taking any corrective steps. Evidence: IEA. (OMIM:605909)
- Depression (HP:0000716): Frequently experiencing feelings of being down, miserable, and/or hopeless; struggling to recover from these moods; having a pessimistic outlook on the future; feeling a pervasive sense of shame; having a low self-worth; experiencing thoughts of suicide and engaging in suicidal behavior. Evidence: IEA. (OMIM:605909)
- Dementia (HP:0000726): A loss of global cognitive ability of sufficient amount to interfere with normal social or occupational function. Dementia represents a loss of previously present cognitive abilities, generally in adults, and can affect memory, thinking, language, judgment, and behavior. Evidence: IEA. (OMIM:605909)
- Anxiety (HP:0000739): Intense feelings of nervousness, tension, or panic often arise in response to interpersonal stresses. There is worry about the negative effects of past unpleasant experiences and future negative possibilities. Individuals may feel fearful, apprehensive, or threatened by uncertainty, and they may also have fears of falling apart or losing control. Evidence: IEA. (OMIM:605909)
- Autosomal recessive inheritance (HP:0000007): A mode of inheritance that is observed for traits related to a gene encoded on one of the autosomes (i.e., the human chromosomes 1-22) in which a trait manifests in individuals with two pathogenic alleles, either homozygotes (two copies of the same mutant allele) or compound heterozygotes (whereby each copy of a gene has a distinct mutant allele). Evidence: IEA. (OMIM:605909)
- Slowly progressive (HP:0003677): Applies to a disease manifestation that only slowly increases in scope or severity over the course of time. Evidence: IEA. (OMIM:605909)
- Hyperreflexia (HP:0001347): Hyperreflexia is the presence of hyperactive stretch reflexes of the muscles. Evidence: IEA. (OMIM:605909)
These phenotypes are associated with the disease autosomal recessive early-onset Parkinson disease 6 (OMIM:605909).